- Absent eyebrow (HP:0002223): Absence of the eyebrow. Evidence: PCS. (PMID:21797849)
- Curly hair (HP:0002212). Evidence: PCS. (PMID:21797849)
- Peripheral axonal neuropathy (HP:0003477): An abnormality characterized by disruption of the normal functioning of peripheral axons. Evidence: PCS. (PMID:21797849)
- Fine hair (HP:0002213): Hair that is fine or thin to the touch. Evidence: TAS. (OMIM:615278)
- Anteverted nares (HP:0000463): Anteriorly-facing nostrils viewed with the head in the Frankfurt horizontal and the eyes of the observer level with the eyes of the subject. This gives the appearance of an upturned nose (upturned nasal tip). Evidence: TAS. (OMIM:615278)
- Global developmental delay (HP:0001263): A delay in the achievement of motor or mental milestones in the domains of development of a child, including motor skills, speech and language, cognitive skills, and social and emotional skills. This term should only be used to describe children younger than five years of age. Evidence: PCS. (PMID:21797849)
- Coarse facial features (HP:0000280): Absence of fine and sharp appearance of brows, nose, lips, mouth, and chin, usually because of rounded and heavy features or thickened skin with or without thickening of subcutaneous and bony tissues. Evidence: TAS. (OMIM:615278)
- Sparse hair (HP:0008070): Reduced density of hairs. Evidence: TAS. (OMIM:615278)
- Ptosis (HP:0000508): The upper eyelid margin is positioned 3 mm or more lower than usual and covers the superior portion of the iris (objective); or, the upper lid margin obscures at least part of the pupil (subjective). Evidence: TAS. (OMIM:615278)
- Broad forehead (HP:0000337): Width of the forehead or distance between the frontotemporales is more than two standard deviations above the mean (objective); or apparently increased distance between the two sides of the forehead. Evidence: PCS. (PMID:21797849)
- High palate (HP:0000218): Height of the palate more than 2 SD above the mean (objective) or palatal height at the level of the first permanent molar more than twice the height of the teeth (subjective). Evidence: PCS. (PMID:21797849)
- Autosomal dominant inheritance (HP:0000006): A mode of inheritance that is observed for traits related to a gene encoded on one of the autosomes (i.e., the human chromosomes 1-22) in which a trait manifests in heterozygotes. In the context of medical genetics, an autosomal dominant disorder is caused when a single copy of the mutant allele is present. Males and females are affected equally, and can both transmit the disorder with a risk of 50% for each child of inheriting the mutant allele. Evidence: PCS. (PMID:21797849)
- Myopia (HP:0000545): An abnormality of refraction characterized by the ability to see objects nearby clearly, while objects in the distance appear blurry. Evidence: PCS. (PMID:21797849)
- Mitral valve prolapse (HP:0001634): One or both of the leaflets (cusps) of the mitral valve bulges back into the left atrium upon contraction of the left ventricle. Evidence: PCS. (PMID:21797849)
- Posteriorly rotated ears (HP:0000358): A type of abnormal location of the ears in which the position of the ears is characterized by posterior rotation (the superior part of the ears is rotated towards the back of the head, and the inferior part of the ears towards the front). Evidence: TAS. (OMIM:615278)
- Low-set ears (HP:0000369): Upper insertion of the ear to the scalp below an imaginary horizontal line drawn between the inner canthi of the eye and extending posteriorly to the ear. Evidence: TAS. (OMIM:615278)
These phenotypes are associated with the disease cardiofaciocutaneous syndrome 2 (OMIM:615278).